- Lumbar spinal canal stenosis (HP:0004610): An abnormal narrowing of the lumbar spinal canal. Evidence: IEA. (OMIM:152550)
- Autosomal dominant inheritance (HP:0000006): A mode of inheritance that is observed for traits related to a gene encoded on one of the autosomes (i.e., the human chromosomes 1-22) in which a trait manifests in heterozygotes. In the context of medical genetics, an autosomal dominant disorder is caused when a single copy of the mutant allele is present. Males and females are affected equally, and can both transmit the disorder with a risk of 50% for each child of inheriting the mutant allele. Evidence: IEA. (OMIM:152550)
These phenotypes are associated with the disease lumbar stenosis, familial (OMIM:152550).